Phenotypes associated with the disease retinitis pigmentosa 49 (OMIM:613756):
- Spicular pigmentation of the retina (HP:0007737): Pigment migration into the retina in a bone-spicule configuration (resembling the nucleated cells within the lacuna of bone). Evidence: PCS. Frequency: 7/7. (PMID:15570217)
- Nyctalopia (HP:0000662): Inability to see well at night or in poor light. Evidence: PCS. Frequency: 7/7. Onset: Childhood onset (HP:0011463). (PMID:15570217)
- Autosomal recessive inheritance (HP:0000007): A mode of inheritance that is observed for traits related to a gene encoded on one of the autosomes (i.e., the human chromosomes 1-22) in which a trait manifests in individuals with two pathogenic alleles, either homozygotes (two copies of the same mutant allele) or compound heterozygotes (whereby each copy of a gene has a distinct mutant allele). Evidence: PCS. (PMID:7479749)
- Reduced visual acuity (HP:0007663). Evidence: TAS. Frequency: 7/7. (PMID:15570217)
- Peripheral visual field loss (HP:0007994): Loss of peripheral vision with retention of central vision, resulting in a constricted circular tunnel-like field of vision. Evidence: PCS. Frequency: 7/7. (PMID:15570217)
- Rod-cone dystrophy (HP:0000510): An inherited retinal disease subtype in which the rod photoreceptors appear to be more severely affected than the cone photoreceptors. Typical presentation is with nyctalopia (due to rod dysfunction) followed by loss of mid-peripheral field of vision, which gradually extends and leaves many patients with a small central island of vision due to the preservation of macular cones. Evidence: PCS. (PMID:7479749)
- Optic disc pallor (HP:0000543): A pale yellow discoloration of the optic disc (the area of the optic nerve head in the retina). The optic disc normally has a pinkish hue with a central yellowish depression. Evidence: PCS. Frequency: 7/7. (PMID:15570217)
- Attenuation of retinal blood vessels (HP:0007843): Narrowing of the retinal blood vessels, both arterioles and venules. Evidence: PCS. Frequency: 7/7. (PMID:15570217)